- Pilomatrixoma (HP:0030434): Pilomatricoma is an asymptomatic slowly growing benign cutaneous tumor, differentiating towards the hair matrix of the hair follicle. It is covered by normal or hyperemic skin, and usually varies in size from 0.5 to 3 cm. Evidence: PCS. (PMID:10192393)
- Typified by somatic mosaicism (HP:0001442): Description of conditions in which affected individuals typically display somatic mosaicism, i.e., genetically distinct populations of somatic cells in a given organism caused by DNA mutations, epigenetic alterations of DNA, chromosomal abnormalities or the spontaneous reversion of inherited mutations. In many conditions typified by somatic mosaicism, constitutive mutation is lethal and cases are exclusively or predominantly mosaic. Evidence: PCS. (PMID:10192393)
These phenotypes are associated with the disease pilomatrixoma (OMIM:132600).